Phenotypes associated with the disease isolated agenesis of gallbladder (OMIM:137040):
- Abnormal abdomen morphology (HP:0001438): A structural abnormality of the abdomen ('belly'), that is, the part of the body between the pelvis and the thorax. Evidence: IEA. (OMIM:137040)
- Autosomal dominant inheritance (HP:0000006): A mode of inheritance that is observed for traits related to a gene encoded on one of the autosomes (i.e., the human chromosomes 1-22) in which a trait manifests in heterozygotes. In the context of medical genetics, an autosomal dominant disorder is caused when a single copy of the mutant allele is present. Males and females are affected equally, and can both transmit the disorder with a risk of 50% for each child of inheriting the mutant allele. Evidence: IEA. (OMIM:137040)